- Nystagmus (HP:0000639): Rhythmic, involuntary oscillations of one or both eyes related to abnormality in fixation, conjugate gaze, or vestibular mechanisms. Evidence: PCS. Frequency: 1/1. (PMID:18327255)
- Renal insufficiency (HP:0000083): A reduction in the level of performance of the kidneys in areas of function comprising the concentration of urine, removal of wastes, the maintenance of electrolyte balance, homeostasis of blood pressure, and calcium metabolism. Evidence: PCS. Frequency: 1/1. (PMID:18327255)
- Global developmental delay (HP:0001263): A delay in the achievement of motor or mental milestones in the domains of development of a child, including motor skills, speech and language, cognitive skills, and social and emotional skills. This term should only be used to describe children younger than five years of age. Evidence: PCS. Frequency: 1/1. (PMID:18327255)
- Autosomal recessive inheritance (HP:0000007): A mode of inheritance that is observed for traits related to a gene encoded on one of the autosomes (i.e., the human chromosomes 1-22) in which a trait manifests in individuals with two pathogenic alleles, either homozygotes (two copies of the same mutant allele) or compound heterozygotes (whereby each copy of a gene has a distinct mutant allele). Evidence: PCS. (PMID:18327255)
- Polydactyly (HP:0010442): A congenital anomaly characterized by the presence of supernumerary fingers or toes. Evidence: PCS. Frequency: 0/1. (PMID:18327255)
- Rod-cone dystrophy (HP:0000510): An inherited retinal disease subtype in which the rod photoreceptors appear to be more severely affected than the cone photoreceptors. Typical presentation is with nyctalopia (due to rod dysfunction) followed by loss of mid-peripheral field of vision, which gradually extends and leaves many patients with a small central island of vision due to the preservation of macular cones. Evidence: PCS. Frequency: 1/1. (PMID:18327255)
- Obesity (HP:0001513): Accumulation of substantial excess body fat. Evidence: PCS. Frequency: 1/1. (PMID:18327255)
- Intellectual disability (HP:0001249): The term intellectual disability or intellectual developmental disorder is used to describe significantly sub-average intellectual and adaptive functioning based on clinical assessment and as measured by individually administered, appropriately normed, standardized and validated tests of intellectual functioning and adaptive behavior, with onset during the developmental period from infancy through adolescence. Evidence: PCS. Frequency: 1/1. (PMID:18327255)
These phenotypes are associated with the disease Bardet-Biedl syndrome 14 (OMIM:615991).